- Functional abnormality of the bladder (HP:0000009): Dysfunction of the urinary bladder. Evidence: TAS. Frequency: Very frequent (HP:0040281). (ORPHA:71211)
- Visual loss (HP:0000572): Loss of visual acuity (implying that vision was better at a certain time point in life). Otherwise the term reduced visual acuity should be used (or a subclass of that). Evidence: TAS. Frequency: Very frequent (HP:0040281). (ORPHA:71211)
- Neuronal loss in central nervous system (HP:0002529). Evidence: TAS. Frequency: Very frequent (HP:0040281). (ORPHA:71211)
- Somatic sensory dysfunction (HP:0003474): An abnormality of the primary sensation that is mediated by peripheral nerves (pain, temperature, touch, vibration, joint position). The word hypoesthesia (or hypesthesia) refers to a reduction in cutaneous sensation to a specific type of testing. Evidence: TAS. Frequency: Very frequent (HP:0040281). (ORPHA:71211)
- Paraplegia (HP:0010550): Severe or complete weakness of both lower extremities with sparing of the upper extremities. Evidence: TAS. Frequency: Very frequent (HP:0040281). (ORPHA:71211)
- Peripheral demyelination (HP:0011096): A loss of myelin from the internode regions along myelinated nerve fibers of the peripheral nervous system. Evidence: TAS. Frequency: Very frequent (HP:0040281). (ORPHA:71211)
- Myelitis (HP:0012486): Inflammation of the spinal cord. Evidence: TAS. Frequency: Very frequent (HP:0040281). (ORPHA:71211)
- Autoimmune antibody positivity (HP:0030057): The presence of an antibody in the blood circulation that is directed against the organism's own cells or tissues. Evidence: TAS. Frequency: Very frequent (HP:0040281). (ORPHA:71211)
- Optic neuritis (HP:0100653): Inflammation of the optic nerve. Evidence: TAS. Frequency: Very frequent (HP:0040281). (ORPHA:71211)
- Ocular pain (HP:0200026): An unpleasant sensation characterized by physical discomfort (such as pricking, throbbing, or aching) localized to the eye. Evidence: TAS. Frequency: Very frequent (HP:0040281). (ORPHA:71211)
- Abnormal brain morphology (HP:0012443): A structural abnormality of the brain, which has as its parts the forebrain, midbrain, and hindbrain. Evidence: TAS. Frequency: Frequent (HP:0040282). (ORPHA:71211)
- Anti-aquaporin 4 antibody positivity (HP:0033342): The presence of autoantibodies (immunoglobulins) in the serum that react against aquaporin-4. Evidence: TAS. Frequency: Frequent (HP:0040282). (ORPHA:71211)
- Nausea (HP:0002018): A sensation of unease in the stomach together with an urge to vomit. Evidence: TAS. Frequency: Occasional (HP:0040283). (ORPHA:71211)
- Respiratory failure (HP:0002878): A severe form of respiratory insufficiency characterized by inadequate gas exchange such that the levels of oxygen or carbon dioxide cannot be maintained within normal limits. Evidence: TAS. Frequency: Occasional (HP:0040283). (ORPHA:71211)
- CSF pleocytosis (HP:0012229): An increased white blood cell count in the cerebrospinal fluid. Evidence: TAS. Frequency: Occasional (HP:0040283). (ORPHA:71211)
- Anti-myelin oligodendrocyte glycoprotein antibody positivity (HP:0032492): Presence of antibodies in the serum that react against myelin oligodendrocyte glycoprotein. Evidence: TAS. Frequency: Occasional (HP:0040283). (ORPHA:71211)
- Recurrent singultus (HP:0100247): A contraction of the diaphragm that repeats several times per minute. In humans, the abrupt rush of air into the lungs causes the epiglottis to close, creating a hic sound. Also known as synchronous diaphragmatic flutter (SDF), or singultus, from the Latin singult, the act of catching one's breath while sobbing. The hiccup is an involuntary action involving a reflex arc. Evidence: TAS. Frequency: Occasional (HP:0040283). (ORPHA:71211)
These phenotypes are associated with the disease Neuromyelitis optica spectrum disorder (ORPHA:71211).